- Fever (HP:0001945): Body temperature elevated above the normal range. Evidence: TAS. Frequency: Very frequent (HP:0040281). (ORPHA:57)
- Reduced circulating aldolase concentration (HP:0012545): Concentration of fructose 1,6-bisphosphate aldolase in the blood circulation below the lower limit of normal. Evidence: TAS. Frequency: Very frequent (HP:0040281). (ORPHA:57)
- Muscle weakness (HP:0001324): Reduced strength of muscles. Evidence: TAS. Frequency: Frequent (HP:0040282). (ORPHA:57)
- Hemolytic anemia (HP:0001878): A type of anemia caused by premature destruction of red blood cells (hemolysis). Evidence: TAS. Frequency: Frequent (HP:0040282). (ORPHA:57)
- Myalgia (HP:0003326): Pain in muscle. Evidence: TAS. Frequency: Frequent (HP:0040282). (ORPHA:57)
- EMG: myopathic abnormalities (HP:0003458): The presence of abnormal electromyographic patterns indicative of myopathy, such as small-short polyphasic motor unit potentials. Evidence: TAS. Frequency: Frequent (HP:0040282). (ORPHA:57)
- Viral infection-induced rhabdomyolysis (HP:0003558): Rhabdomyolysis induced by a viral infection. Evidence: TAS. Frequency: Frequent (HP:0040282). (ORPHA:57)
- Skeletal myopathy (HP:0003756). Evidence: TAS. Frequency: Frequent (HP:0040282). (ORPHA:57)
- Elevated creatine kinase after exercise (HP:0008331). Evidence: TAS. Frequency: Frequent (HP:0040282). (ORPHA:57)
- Exercise-induced rhabdomyolysis (HP:0009045): Rhabdomyolysis induced by exercise. Evidence: TAS. Frequency: Frequent (HP:0040282). (ORPHA:57)
- Muscle fiber atrophy (HP:0100295). Evidence: TAS. Frequency: Frequent (HP:0040282). (ORPHA:57)
- Delayed speech and language development (HP:0000750): A degree of language development that is significantly below the norm for a child of a specified age. Evidence: TAS. Frequency: Occasional (HP:0040283). (ORPHA:57)
- Intellectual disability (HP:0001249): The term intellectual disability or intellectual developmental disorder is used to describe significantly sub-average intellectual and adaptive functioning based on clinical assessment and as measured by individually administered, appropriately normed, standardized and validated tests of intellectual functioning and adaptive behavior, with onset during the developmental period from infancy through adolescence. Evidence: TAS. Frequency: Occasional (HP:0040283). (ORPHA:57)
- Motor delay (HP:0001270): A type of Developmental delay characterized by a delay in acquiring motor skills. Evidence: TAS. Frequency: Occasional (HP:0040283). (ORPHA:57)
- Specific learning disability (HP:0001328): Impairment of certain skills such as reading or writing, coordination, self-control, or attention that interfere with the ability to learn. The impairment is not related to a global deficiency of intelligence. Evidence: TAS. Frequency: Occasional (HP:0040283). (ORPHA:57)
- Growth delay (HP:0001510): A deficiency or slowing down of growth pre- and postnatally. Evidence: TAS. Frequency: Occasional (HP:0040283). (ORPHA:57)
- Acute kidney injury (HP:0001919): Sudden loss of renal function, as manifested by decreased urine production, and a rise in serum creatinine or blood urea nitrogen concentration (azotemia). Evidence: TAS. Frequency: Occasional (HP:0040283). (ORPHA:57)
- Hyperkalemia (HP:0002153): The concentration of potassium(1+) in the blood circulation is above the upper limit of normal. Evidence: TAS. Frequency: Occasional (HP:0040283). (ORPHA:57)
- Myoglobinuria (HP:0002913): Presence of myoglobin in the urine. Evidence: TAS. Frequency: Occasional (HP:0040283). (ORPHA:57)
- Decreased muscle mass (HP:0003199). Evidence: TAS. Frequency: Occasional (HP:0040283). (ORPHA:57)
- Arrhythmia (HP:0011675): Any cardiac rhythm other than the normal sinus rhythm. Such a rhythm may be either of sinus or ectopic origin and either regular or irregular. An arrhythmia may be due to a disturbance in impulse formation or conduction or both. Evidence: TAS. Frequency: Occasional (HP:0040283). (ORPHA:57)
These phenotypes are associated with the disease Glycogen storage disease due to aldolase A deficiency (ORPHA:57).